- Recurrent urinary tract infections (HP:0000010): Repeated infections of the urinary tract. Evidence: TAS. (OMIM:300988)
- Decreased circulating immunoglobulin concentration (HP:0004313): An abnormally decreased level of immunoglobulin in blood. Evidence: TAS. (OMIM:300988)
- X-linked recessive inheritance (HP:0001419): A mode of inheritance that is observed for recessive traits related to a gene encoded on the X chromosome. In the context of medical genetics, X-linked recessive disorders manifest in males (who have one copy of the X chromosome and are thus hemizygotes), but generally not in female heterozygotes who have one mutant and one normal allele. Evidence: TAS. (OMIM:300988)
- Decreased total lymphocyte count (HP:0001888): A reduced number of lymphocytes in the blood. Evidence: TAS. (OMIM:300988)
- Eczematoid dermatitis (HP:0000964): Eczema is a form of dermatitis that is characterized by scaly, pruritic, erythematous lesions located on flexural surfaces. Evidence: TAS. (OMIM:300988)
- Recurrent respiratory infections (HP:0002205): An increased susceptibility to respiratory infections as manifested by a history of recurrent respiratory infections. Evidence: TAS. (OMIM:300988)
- Decreased total neutrophil count (HP:0001875): Abnormal decrease of absolute number of neutrophils in the blood, per microlitre, compared to a reference range for a given sex and age-group. Evidence: IEA. (OMIM:300988)
These phenotypes are associated with the disease combined immunodeficiency due to moesin deficiency (OMIM:300988).